- Pericardial effusion (HP:0001698): Accumulation of fluid within the pericardium. Evidence: TAS. Frequency: Very frequent (HP:0040281). (ORPHA:48686)
- Abdominal pain (HP:0002027): An unpleasant sensation characterized by physical discomfort (such as pricking, throbbing, or aching) and perceived to originate in the abdomen. Evidence: TAS. Frequency: Very frequent (HP:0040281). (ORPHA:48686)
- Dyspnea (HP:0002094): Difficult or labored breathing. Dyspnea is a subjective feeling only the patient can rate, e.g., on a Borg scale. Evidence: TAS. Frequency: Very frequent (HP:0040281). (ORPHA:48686)
- Pleural effusion (HP:0002202): The presence of an excessive amount of fluid in the pleural cavity. Evidence: TAS. Frequency: Very frequent (HP:0040281). (ORPHA:48686)
- Abnormal peritoneum morphology (HP:0002585): An abnormality of the peritoneum. Evidence: TAS. Frequency: Very frequent (HP:0040281). (ORPHA:48686)
- Immunodeficiency (HP:0002721): Failure of the immune system to protect the body adequately from infection, due to the absence or insufficiency of some component process or substance. Evidence: TAS. Frequency: Frequent (HP:0040282). (ORPHA:48686)
- Abdominal distention (HP:0003270): Distention of the abdomen. Evidence: TAS. Frequency: Very frequent (HP:0040281). (ORPHA:48686)
- B-cell lymphoma (HP:0012191): A type of lymphoma that originates in B-cells. Evidence: TAS. Frequency: Very frequent (HP:0040281). (ORPHA:48686)
These phenotypes are associated with the disease Primary effusion lymphoma (ORPHA:48686).